Phenotypes associated with the disease tetralogy of fallot (OMIM:187500):
- Preauricular pit (HP:0004467): Small indentation anterior to the insertion of the ear. Evidence: IEA. (OMIM:187500)
- Tetralogy of Fallot (HP:0001636): A congenital cardiac malformation comprising pulmonary stenosis, overriding aorta, ventricular septum defect, and right ventricular hypertrophy. The diagnosis of TOF is made if at least three of the four above mentioned features are present. Evidence: IEA. (OMIM:187500)
- Broad forehead (HP:0000337): Width of the forehead or distance between the frontotemporales is more than two standard deviations above the mean (objective); or apparently increased distance between the two sides of the forehead. Evidence: IEA. (OMIM:187500)
- Clinodactyly of the 5th finger (HP:0004209): Clinodactyly refers to a bending or curvature of the fifth finger in the radial direction (i.e., towards the 4th finger). Evidence: IEA. (OMIM:187500)
- Proptosis (HP:0000520): An eye that is protruding anterior to the plane of the face to a greater extent than is typical. Evidence: IEA. (OMIM:187500)
- Autosomal dominant inheritance (HP:0000006): A mode of inheritance that is observed for traits related to a gene encoded on one of the autosomes (i.e., the human chromosomes 1-22) in which a trait manifests in heterozygotes. In the context of medical genetics, an autosomal dominant disorder is caused when a single copy of the mutant allele is present. Males and females are affected equally, and can both transmit the disorder with a risk of 50% for each child of inheriting the mutant allele. Evidence: IEA. (OMIM:187500)